Phenotypes associated with the disease DPM1-CDG (ORPHA:79322):
- Seizure (HP:0001250): A seizure is an intermittent abnormality of nervous system physiology characterized by a transient occurrence of signs and/or symptoms due to abnormal excessive or synchronous neuronal activity in the brain. Evidence: TAS. Frequency: Very frequent (HP:0040281). (ORPHA:79322)
- Elevated circulating creatine kinase activity (HP:0003236): The activity of creatine kinase in the blood circulation is above the upper limit of normal. Evidence: TAS. Frequency: Very frequent (HP:0040281). (ORPHA:79322)
- Secondary microcephaly (HP:0005484): Head circumference which falls below 2 standard deviations below the mean for age and gender because of insufficient head growth after birth. Evidence: TAS. Frequency: Very frequent (HP:0040281). (ORPHA:79322)
- Floppy infant (HP:0008947): Floppiness/hypotonia is defined as reduced resistance to passive movement of joints. Physical examination of floppy/hypotonic infants shows head lag, lack of shoulder and elbow muscle contraction on traction response, inability to tighten the shoulder girdle muscles (or slipping through) when held under the axillae, scarf sign (when the arm is pulled to the opposite side, the arm wraps around the neck with the elbow crossing midline), hyperdorsiflexion of the feet, easy apposition of the thumb against the forearm, feet touching the cheek with ease and without discomfort, frog leg position, and inverted U sign on ventral suspension (head, arms, and legs hanging down without elbow or knee flexion and the trunk rounded in a dome shape). Evidence: TAS. Frequency: Very frequent (HP:0040281). (ORPHA:79322)
- Neurodevelopmental delay (HP:0012758): Neurodevelopmental delay (NDD) refers to delays in the maturation of the brain and central nervous system; infants and young children with NDD may experience delays in the development of one or more skills including gross motor abilities, fine-motor coordination, language abilities and ability to solve increasingly complex problems. Evidence: TAS. Frequency: Very frequent (HP:0040281). (ORPHA:79322)
- Hypertelorism (HP:0000316): Interpupillary distance more than 2 SD above the mean (alternatively, the appearance of an increased interpupillary distance or widely spaced eyes). Evidence: TAS. Frequency: Frequent (HP:0040282). (ORPHA:79322)
- Failure to thrive (HP:0001508): Failure to thrive (FTT) refers to a child whose physical growth is substantially below the norm. Evidence: TAS. Frequency: Frequent (HP:0040282). (ORPHA:79322)
- Reduced antithrombin III activity (HP:0001976): An abnormality of coagulation related to a decreased concentration of antithrombin-III. Evidence: TAS. Frequency: Frequent (HP:0040282). (ORPHA:79322)
- High, narrow palate (HP:0002705): The presence of a high and narrow palate. Evidence: TAS. Frequency: Frequent (HP:0040282). (ORPHA:79322)
- Elevated circulating hepatic transaminase concentration (HP:0002910): Elevations of the levels of SGOT and SGPT in the serum. SGOT (serum glutamic oxaloacetic transaminase) and SGPT (serum glutamic pyruvic transaminase) are transaminases primarily found in the liver and heart and are released into the bloodstream as the result of liver or heart damage. SGOT and SGPT are used clinically mainly as markers of liver damage. Evidence: TAS. Frequency: Frequent (HP:0040282). (ORPHA:79322)
- Reduced protein S activity (HP:0004855): An abnormality of coagulation related to a decreased concentration of vitamin K-dependent protein S. Protein S is a cofactor of protein C. Evidence: TAS. Frequency: Frequent (HP:0040282). (ORPHA:79322)
- Reduced protein C activity (HP:0005543): An abnormality of coagulation related to a decreased concentration of vitamin K-dependent protein C. Protein C is activated to protein Ca by thrombin bound to thrombomodulin. Activated protein C degrades factors VIIIa and Va. Evidence: TAS. Frequency: Frequent (HP:0040282). (ORPHA:79322)
- Delayed myelination (HP:0012448): Delayed myelination. Evidence: TAS. Frequency: Frequent (HP:0040282). (ORPHA:79322)
- Abnormal dentate nucleus morphology (HP:0100321): An abnormality of the dentate nucleus. Evidence: TAS. Frequency: Frequent (HP:0040282). (ORPHA:79322)
- Trigonocephaly (HP:0000243): Wedge-shaped, or triangular head, with the apex of the triangle at the midline of the forehead and the base of the triangle at the occiput. Evidence: TAS. Frequency: Occasional (HP:0040283). (ORPHA:79322)
- Full cheeks (HP:0000293): Increased prominence or roundness of soft tissues between zygomata and mandible. Evidence: TAS. Frequency: Occasional (HP:0040283). (ORPHA:79322)
- Smooth philtrum (HP:0000319): Flat skin surface, with no ridge formation in the central region of the upper lip between the nasal base and upper vermilion border. Evidence: TAS. Frequency: Occasional (HP:0040283). (ORPHA:79322)
- Micrognathia (HP:0000347): Developmental hypoplasia of the mandible. Evidence: TAS. Frequency: Occasional (HP:0040283). (ORPHA:79322)
- Strabismus (HP:0000486): A misalignment of the eyes so that the visual axes deviate from bifoveal fixation. The classification of strabismus may be based on a number of features including the relative position of the eyes, whether the deviation is latent or manifest, intermittent or constant, concomitant or otherwise and according to the age of onset and the relevance of any associated refractive error. Evidence: TAS. Frequency: Occasional (HP:0040283). (ORPHA:79322)
- Retinopathy (HP:0000488): Any noninflammatory disease of the retina. This nonspecific term is retained here because of its wide use in the literature, but if possible new annotations should indicate the precise type of retinal abnormality. Evidence: TAS. Frequency: Occasional (HP:0040283). (ORPHA:79322)
- Downslanted palpebral fissures (HP:0000494): The palpebral fissure inclination is more than two standard deviations below the mean. Evidence: TAS. Frequency: Occasional (HP:0040283). (ORPHA:79322)
- Esotropia (HP:0000565): A form of strabismus with one or both eyes turned inward ('crossed') to a relatively severe degree, usually defined as 10 diopters or more. Evidence: TAS. Frequency: Occasional (HP:0040283). (ORPHA:79322)
- Nystagmus (HP:0000639): Rhythmic, involuntary oscillations of one or both eyes related to abnormality in fixation, conjugate gaze, or vestibular mechanisms. Evidence: TAS. Frequency: Occasional (HP:0040283). (ORPHA:79322)
- Optic atrophy (HP:0000648): Atrophy of the optic nerve. Optic atrophy results from the death of the retinal ganglion cell axons that comprise the optic nerve and manifesting as a pale optic nerve on fundoscopy. Evidence: TAS. Frequency: Occasional (HP:0040283). (ORPHA:79322)
- Ataxia (HP:0001251): Ataxia refers to impaired coordination of voluntary muscle movement. Cerebellar ataxia refers to ataxia due to dysfunction of the cerebellum. This causes a variety of elementary neurological deficits including asynergy (lack of coordination between muscles, limbs and joints), dysmetria (lack of ability to judge distances that can lead to under- or overshoot in grasping movements), and dysdiadochokinesia (inability to perform rapid movements requiring antagonizing muscle groups to be switched on and off repeatedly). Evidence: TAS. Frequency: Occasional (HP:0040283). (ORPHA:79322)
- Spasticity (HP:0001257): A motor disorder characterized by a velocity-dependent increase in tonic stretch reflexes with increased muscle tone, exaggerated (hyperexcitable) tendon reflexes. Evidence: TAS. Frequency: Occasional (HP:0040283). (ORPHA:79322)
- Cerebellar atrophy (HP:0001272): Cerebellar atrophy is defined as a cerebellum with initially normal structures, in a posterior fossa with normal size, which displays enlarged fissures (interfolial spaces) in comparison to the foliae secondary to loss of tissue. Cerebellar atrophy implies irreversible loss of tissue and result from an ongoing progressive disease until a final stage is reached or a single injury, e.g. an intoxication or infectious event. Evidence: TAS. Frequency: Occasional (HP:0040283). (ORPHA:79322)
- Encephalopathy (HP:0001298): Encephalopathy is a term that means brain disease, damage, or malfunction. In general, encephalopathy is manifested by an altered mental state. Evidence: TAS. Frequency: Occasional (HP:0040283). (ORPHA:79322)
- Hepatic fibrosis (HP:0001395): The presence of excessive fibrous connective tissue in the liver. Fibrosis is a reparative or reactive process. Evidence: TAS. Frequency: Occasional (HP:0040283). (ORPHA:79322)
- Hepatic steatosis (HP:0001397): Steatosis is a term used to denote lipid accumulation within hepatocytes. Evidence: TAS. Frequency: Occasional (HP:0040283). (ORPHA:79322)
- Hepatosplenomegaly (HP:0001433): Simultaneous enlargement of the liver and spleen. Evidence: TAS. Frequency: Occasional (HP:0040283). (ORPHA:79322)
- Long hallux (HP:0001847): Increased length of the big toe. Evidence: TAS. Frequency: Occasional (HP:0040283). (ORPHA:79322)
- Sandal gap (HP:0001852): A widely spaced gap between the first toe (the great toe) and the second toe. Evidence: TAS. Frequency: Occasional (HP:0040283). (ORPHA:79322)
- Diarrhea (HP:0002014): Abnormally increased frequency (usually defined as three or more) loose or watery bowel movements a day. Evidence: TAS. Frequency: Occasional (HP:0040283). (ORPHA:79322)
- Prominent glabella (HP:0002057): Forward protrusion of the glabella. Evidence: TAS. Frequency: Occasional (HP:0040283). (ORPHA:79322)
- Cerebral atrophy (HP:0002059): Atrophy (wasting, decrease in size of cells or tissue) affecting the cerebrum. Evidence: TAS. Frequency: Occasional (HP:0040283). (ORPHA:79322)
- Ventriculomegaly (HP:0002119): An increase in size of the ventricular system of the brain. Evidence: TAS. Frequency: Occasional (HP:0040283). (ORPHA:79322)
- Generalized myoclonic seizure (HP:0002123): A generalized myoclonic seizure is a type of generalized motor seizure characterized by bilateral, sudden, brief (<100 ms) involuntary single or multiple contraction of muscles or muscle groups of variable topography (axial, proximal limb, distal). Myoclonus is less regularly repetitive and less sustained than is clonus. Evidence: TAS. Frequency: Occasional (HP:0040283). (ORPHA:79322)
- Nail dysplasia (HP:0002164): The presence of developmental dysplasia of the nail. Evidence: TAS. Frequency: Occasional (HP:0040283). (ORPHA:79322)
- Hepatomegaly (HP:0002240): Abnormally increased size of the liver. Evidence: TAS. Frequency: Occasional (HP:0040283). (ORPHA:79322)
- Inverted nipples (HP:0003186): The presence of nipples that instead of pointing outward are retracted inwards. Evidence: TAS. Frequency: Occasional (HP:0040283). (ORPHA:79322)
- External genital hypoplasia (HP:0003241): Underdevelopment of part or all of the external reproductive organs. Evidence: TAS. Frequency: Occasional (HP:0040283). (ORPHA:79322)
- Muscular dystrophy (HP:0003560): The term dystrophy means abnormal growth. However, muscular dystrophy is used to describe primary myopathies with a genetic basis and a progressive course characterized by progressive skeletal muscle weakness and wasting, defects in muscle proteins, and histological features of muscle fiber degeneration (necrosis) and regeneration. If possible, it is preferred to use other HPO terms to describe the precise phenotypic abnormalities. Evidence: TAS. Frequency: Occasional (HP:0040283). (ORPHA:79322)
- Depressed nasal bridge (HP:0005280): Posterior positioning of the nasal root in relation to the overall facial profile for age. Evidence: TAS. Frequency: Occasional (HP:0040283). (ORPHA:79322)
- Flat occiput (HP:0005469): Reduced convexity of the occiput (posterior part of skull). Evidence: TAS. Frequency: Occasional (HP:0040283). (ORPHA:79322)
- Knee flexion contracture (HP:0006380): A type of knee joint contracture in which the knee is in a fixed bent (flexed) configuration such that it cannot be straightened actively or passively. Evidence: TAS. Frequency: Occasional (HP:0040283). (ORPHA:79322)
- Pontocerebellar atrophy (HP:0006879): Atrophy affecting the pons and the cerebellum. Evidence: TAS. Frequency: Occasional (HP:0040283). (ORPHA:79322)
- Hypoplasia of the frontal lobes (HP:0007333): Underdevelopment of the frontal lobe of the cerebrum. Evidence: TAS. Frequency: Occasional (HP:0040283). (ORPHA:79322)
- Limb undergrowth (HP:0009826): Limb shortening because of underdevelopment of one or more bones of the extremities. Evidence: TAS. Frequency: Occasional (HP:0040283). (ORPHA:79322)
- Peripheral neuropathy (HP:0009830): Peripheral neuropathy is a general term for any disorder of the peripheral nervous system. The main clinical features used to classify peripheral neuropathy are distribution, type (mainly demyelinating versus mainly axonal), duration, and course. Evidence: TAS. Frequency: Occasional (HP:0040283). (ORPHA:79322)
- Tented upper lip vermilion (HP:0010804): Triangular appearance of the oral aperture with the apex in the midpoint of the upper vermilion and the lower vermilion forming the base. Evidence: TAS. Frequency: Occasional (HP:0040283). (ORPHA:79322)
- U-Shaped upper lip vermilion (HP:0010806): Gentle upward curve of the upper lip vermilion such that the center is placed well superior to the commissures. Evidence: TAS. Frequency: Occasional (HP:0040283). (ORPHA:79322)
- Generalized tonic seizure (HP:0010818): A generalized tonic seizure is a type of generalized motor seizure characterized by bilateral limb stiffening or elevation, often with neck stiffening without a subsequent clonic phase. The tonic activity can be a sustained abnormal posture, either in extension or flexion, sometimes accompanied by tremor of the extremities. Evidence: TAS. Frequency: Occasional (HP:0040283). (ORPHA:79322)
- Atonic seizure (HP:0010819): Atonic seizure is a type of motor seizure characterized by a sudden loss or diminution of muscle tone without apparent preceding myoclonic or tonic event lasting about 1 to 2 seconds, involving head, trunk, jaw, or limb musculature. Evidence: TAS. Frequency: Occasional (HP:0040283). (ORPHA:79322)
- Early onset absence seizures (HP:0011152): Typical absence seizures starting before the age of 4 years. Evidence: TAS. Frequency: Occasional (HP:0040283). (ORPHA:79322)
- Gastrostomy tube feeding in infancy (HP:0011471): Feeding problem necessitating gastrostomy tube feeding. Evidence: TAS. Frequency: Occasional (HP:0040283). (ORPHA:79322)
- Camptodactyly (HP:0012385): The distal interphalangeal joint and/or the proximal interphalangeal joint of the fingers or toes cannot be extended to 180 degrees by either active or passive extension. Evidence: TAS. Frequency: Occasional (HP:0040283). (ORPHA:79322)
- Abnormal visual fixation (HP:0025404): Any anomaly in the process of ocular fixation, which is the maintaining of the visual gaze on a single location. Evidence: TAS. Frequency: Occasional (HP:0040283). (ORPHA:79322)
- Cerebral visual impairment (HP:0100704): A form of loss of vision caused by damage to the visual cortex rather than a defect in the eye. Evidence: TAS. Frequency: Occasional (HP:0040283). (ORPHA:79322)